Phenotypes associated with the disease microcephaly 22, primary, autosomal recessive (OMIM:617984):
- Microcephaly (HP:0000252): Head circumference below 2 standard deviations below the mean for age and gender. Evidence: PCS. Frequency: 2/2. (PMID:27737959)
- Short stature (HP:0004322): A height below that which is expected according to age and gender norms. Although there is no universally accepted definition of short stature, many refer to "short stature" as height more than 2 standard deviations below the mean for age and gender (or below the 3rd percentile for age and gender dependent norms). Evidence: PCS. Frequency: 1/2. (PMID:27737959)
- Seizure (HP:0001250): A seizure is an intermittent abnormality of nervous system physiology characterized by a transient occurrence of signs and/or symptoms due to abnormal excessive or synchronous neuronal activity in the brain. Evidence: PCS. Frequency: 1/2. (PMID:27737959)
- Moderate global developmental delay (HP:0011343): A moderate delay in the achievement of motor or mental milestones in the domains of development of a child. Evidence: PCS. Frequency: 1/2. (PMID:27737959)
- Small for gestational age (HP:0001518): Smaller than normal size according to sex and gestational age related norms, defined as a weight below the 10th percentile for the gestational age. Evidence: PCS. Frequency: 1/2. (PMID:27737959)
- Limb hypertonia (HP:0002509). Evidence: PCS. Frequency: 1/2. (PMID:27737959)
- Infantile onset (HP:0003593): Onset of signs or symptoms of disease between 28 days to one year of life. Evidence: PCS. Frequency: 2/2. (PMID:27737959)
- Autosomal recessive inheritance (HP:0000007): A mode of inheritance that is observed for traits related to a gene encoded on one of the autosomes (i.e., the human chromosomes 1-22) in which a trait manifests in individuals with two pathogenic alleles, either homozygotes (two copies of the same mutant allele) or compound heterozygotes (whereby each copy of a gene has a distinct mutant allele). Evidence: PCS. (PMID:27737959)